- Myocardial fibrosis (HP:0001685): Myocardial fibrosis is characterized by dysregulated collagen turnover (increased synthesis predominates over unchanged or decreased degradation) and excessive diffuse collagen accumulation in the interstitial and perivascular spaces as well as by phenotypically transformed fibroblasts, termed myofibroblasts. Evidence: IEA. (OMIM:613873)
- Hypertrophic cardiomyopathy (HP:0001639): Hypertrophic cardiomyopathy (HCM) is defined by the presence of increased ventricular wall thickness or mass in the absence of loading conditions (hypertension, valve disease) sufficient to cause the observed abnormality. Evidence: PCS. Frequency: 3/3. (PMID:17509612)
- Young adult onset (HP:0011462): Onset of disease at the age of between 16 and 40 years. Evidence: PCS. Frequency: 3/3. (PMID:17509612)
- Angina pectoris (HP:0001681): Paroxysmal chest pain that occurs with exertion or stress and is related to myocardial ischemia. Evidence: PCS. Frequency: 1/3. (PMID:17509612)
- Atrial fibrillation (HP:0005110): An atrial arrhythmia characterized by disorganized atrial activity without discrete P waves on the surface EKG, but instead by an undulating baseline or more sharply circumscribed atrial deflections of varying amplitude an frequency ranging from 350 to 600 per minute. Evidence: PCS. Frequency: 0/3. (PMID:17509612)
- Dyspnea (HP:0002094): Difficult or labored breathing. Dyspnea is a subjective feeling only the patient can rate, e.g., on a Borg scale. Evidence: PCS. Frequency: 3/3. (PMID:17509612)
- Left ventricular hypertrophy (HP:0001712): Enlargement or increased size of the heart left ventricle. Evidence: PCS. Frequency: 3/3. (PMID:17509612)
- Palpitations (HP:0001962): A sensation that the heart is pounding or racing, which is a non-specific sign but may be a manifestation of arrhythmia. Evidence: PCS. Frequency: 1/3. (PMID:17509612)
- Autosomal dominant inheritance (HP:0000006): A mode of inheritance that is observed for traits related to a gene encoded on one of the autosomes (i.e., the human chromosomes 1-22) in which a trait manifests in heterozygotes. In the context of medical genetics, an autosomal dominant disorder is caused when a single copy of the mutant allele is present. Males and females are affected equally, and can both transmit the disorder with a risk of 50% for each child of inheriting the mutant allele. Evidence: PCS. (PMID:17509612)
- Ventricular tachycardia (HP:0004756): A tachycardia originating in the ventricles characterized by rapid heart rate (over 100 beats per minute) and broad QRS complexes (over 120 ms). Evidence: TAS. Frequency: Occasional (HP:0040283). (OMIM:613873)
These phenotypes are associated with the disease hypertrophic cardiomyopathy 17 (OMIM:613873).